Phenotypes associated with the disease epilepsy, juvenile myoclonic, susceptibility to, 10 (OMIM:617924):
- Bilateral tonic-clonic seizure (HP:0002069): A bilateral tonic-clonic seizure is a seizure defined by a tonic (bilateral increased tone, lasting seconds to minutes) and then a clonic (bilateral sustained rhythmic jerking) phase. Evidence: PCS. Frequency: 1/13. (PMID:29539279)
- Juvenile onset (HP:0003621): Onset of signs or symptoms of disease between the age of 5 and 15 years. Evidence: PCS. Frequency: 10/13. (PMID:29539279)
- Generalized myoclonic seizure (HP:0002123): A generalized myoclonic seizure is a type of generalized motor seizure characterized by bilateral, sudden, brief (<100 ms) involuntary single or multiple contraction of muscles or muscle groups of variable topography (axial, proximal limb, distal). Myoclonus is less regularly repetitive and less sustained than is clonus. Evidence: PCS. Frequency: 7/13. (PMID:29539279)
- Febrile seizure (within the age range of 3 months to 6 years) (HP:0002373): A febrile seizure is any type of seizure (most often a generalized tonic-clonic seizure) occurring with fever (at least 38 degrees Celsius) but in the absence of central nervous system infection, severe metabolic disturbance or other alternative precipitant in children between the ages of 3 months and 6 years. Evidence: PCS. Frequency: 4/13. (PMID:29539279)
- Generalized non-motor (absence) seizure (HP:0002121): A generalized non-motor (absence) seizure is a type of a type of dialeptic seizure that is of electrographically generalized onset. It is a generalized seizure characterized by an interruption of activities, a blank stare, and usually the person will be unresponsive when spoken to. Any ictal motor phenomena are minor in comparison to these non-motor features. Evidence: PCS. Frequency: 5/13. (PMID:29539279)
- Childhood onset (HP:0011463): Onset of disease at the age of between 1 and 5 years. Evidence: PCS. Frequency: 1/13. (PMID:29539279)
- Typified by incomplete penetrance (HP:0003829): Description of conditions in which not all individuals with a given genotype exhibit the disease. Penetrance is the proportion that develop disease given a lifespan of 80 years. Evidence: PCS. (PMID:29539279)
- Autosomal dominant inheritance (HP:0000006): A mode of inheritance that is observed for traits related to a gene encoded on one of the autosomes (i.e., the human chromosomes 1-22) in which a trait manifests in heterozygotes. In the context of medical genetics, an autosomal dominant disorder is caused when a single copy of the mutant allele is present. Males and females are affected equally, and can both transmit the disorder with a risk of 50% for each child of inheriting the mutant allele. Evidence: PCS. (PMID:29539279)
- Neonatal onset (HP:0003623): Onset of signs or symptoms of disease within the first 28 days of life. Evidence: PCS. Frequency: 1/13. (PMID:29539279)